- Septate vagina (HP:0001153): The presence of a vaginal septum, thereby creating a vaginal duplication. The septum is longitudinal in the majority of cases. Evidence: TAS. Frequency: Frequent (HP:0040282). (ORPHA:1319)
- Brachydactyly (HP:0001156): Digits that appear disproportionately short compared to the hand/foot. The word brachydactyly is used here to describe a series distinct patterns of shortened digits (brachydactyly types A-E). This is the sense used here. Evidence: TAS. Frequency: Very frequent (HP:0040281). (ORPHA:1319)
- Abnormal fingernail morphology (HP:0001231): An abnormality of the fingernails. Evidence: TAS. Frequency: Occasional (HP:0040283). (ORPHA:1319)
- Toe syndactyly (HP:0001770): Webbing or fusion of the toes, involving soft parts only or including bone structure. Bony fusions are referred to as "bony" Syndactyly if the fusion occurs in a radio-ulnar axis. Fusions of bones of the toes in a proximo-distal axis are referred to as "Symphalangism". Evidence: TAS. Frequency: Frequent (HP:0040282). (ORPHA:1319)
- Hypoplastic toenails (HP:0001800): Underdevelopment of the toenail. Evidence: TAS. Frequency: Occasional (HP:0040283). (ORPHA:1319)
- Finger syndactyly (HP:0006101): Webbing or fusion of the fingers, involving soft parts only or including bone structure. Bony fusions are referred to as "bony" Syndactyly if the fusion occurs in a radio-ulnar axis. Fusions of bones of the fingers in a proximo-distal axis are referred to as "Symphalangism". Evidence: TAS. Frequency: Frequent (HP:0040282). (ORPHA:1319)
- Ulnar deviation of finger (HP:0009465): Bending or curvature of a finger toward the ulnar side (i.e., away from the thumb). The deviation is at the metacarpal-phalangeal joint, and this finding is distinct from clinodactyly. Evidence: TAS. Frequency: Frequent (HP:0040282). (ORPHA:1319)
- Aplasia/Hypoplasia of the thumb (HP:0009601): Hypoplastic/small or absent thumb. Evidence: TAS. Frequency: Occasional (HP:0040283). (ORPHA:1319)
- Camptodactyly of finger (HP:0100490): The distal interphalangeal joint and/or the proximal interphalangeal joint of the fingers cannot be extended to 180 degrees by either active or passive extension. Evidence: TAS. Frequency: Very frequent (HP:0040281). (ORPHA:1319)
These phenotypes are associated with the disease Camptobrachydactyly (ORPHA:1319).